Phenotypes associated with the disease microcephaly 25, primary, autosomal recessive (OMIM:618351):
- Congenital onset (HP:0003577): A phenotypic abnormality that is present at birth. Evidence: PCS. Frequency: 3/3. (PMID:30715179)
- Delayed speech and language development (HP:0000750): A degree of language development that is significantly below the norm for a child of a specified age. Evidence: PCS. Frequency: 3/3. (PMID:30715179)
- Tethered cord (HP:0002144): During normal embryological development, the spinal cord first occupies the entire length of the vertebral column but goes on to assume a position at the level of L1 due to differential growth of the conus medullaris and the vertebral column. The filum terminale is a slender, threadlike structure that remains after the normal regression of the distal embryonic spinal cord and attaches the spinal cord to the coccyx. A tethered cord results if there is a thickened rope-like filum terminale which anchors the cord at the level of L2 or below, potentially causing neurologic signs owing to abnormal tension on the spinal cord. Evidence: PCS. Frequency: 1/3. (PMID:30715179)
- Filum terminale lipoma (HP:6000184): Filum terminale lipomas (FTLs) are a type of lumbosacral lipoma in which the fat is entirely within the filum terminale and separate from the conus medullaris. Evidence: PCS. Frequency: 1/3. (PMID:30715179)
- Hypoplasia of the corpus callosum (HP:0002079): Underdevelopment of the corpus callosum. Evidence: PCS. Frequency: 3/3. (PMID:30715179)
- Global developmental delay (HP:0001263): A delay in the achievement of motor or mental milestones in the domains of development of a child, including motor skills, speech and language, cognitive skills, and social and emotional skills. This term should only be used to describe children younger than five years of age. Evidence: PCS. Frequency: 3/3. (PMID:30715179)
- Primary microcephaly (HP:0011451): Head circumference below 2 standard deviations below the mean for age and gender at birth. Evidence: PCS. Frequency: 3/3. Onset: Congenital onset (HP:0003577). (PMID:30715179)
- Autosomal recessive inheritance (HP:0000007): A mode of inheritance that is observed for traits related to a gene encoded on one of the autosomes (i.e., the human chromosomes 1-22) in which a trait manifests in individuals with two pathogenic alleles, either homozygotes (two copies of the same mutant allele) or compound heterozygotes (whereby each copy of a gene has a distinct mutant allele). Evidence: PCS. (PMID:30715179)
- Attention deficit hyperactivity disorder (HP:0007018): Attention deficit hyperactivity disorder (ADHD) manifests at age 2-3 years or by first grade at the latest. The main symptoms are distractibility, impulsivity, hyperactivity, and often trouble organizing tasks and projects, difficulty going to sleep, and social problems from being aggressive, loud, or impatient. Evidence: PCS. Frequency: 3/3. (PMID:30715179)
- Intellectual disability (HP:0001249): The term intellectual disability or intellectual developmental disorder is used to describe significantly sub-average intellectual and adaptive functioning based on clinical assessment and as measured by individually administered, appropriately normed, standardized and validated tests of intellectual functioning and adaptive behavior, with onset during the developmental period from infancy through adolescence. Evidence: PCS. Frequency: 3/3. (PMID:30715179)